Phenotypes associated with the disease Isolated cerebellar agenesis (ORPHA:1398):
- Microcephaly (HP:0000252): Head circumference below 2 standard deviations below the mean for age and gender. Evidence: TAS. Frequency: Frequent (HP:0040282). (ORPHA:1398)
- Macrocephaly (HP:0000256): Occipitofrontal (head) circumference greater than 97th centile compared to appropriate, age matched, sex-matched normal standards. Alternatively, a apparently increased size of the cranium. Evidence: TAS. Frequency: Frequent (HP:0040282). (ORPHA:1398)
- Abnormality of eye movement (HP:0000496): An abnormality in voluntary or involuntary eye movements or their control. Evidence: TAS. Frequency: Very frequent (HP:0040281). (ORPHA:1398)
- Atypical behavior (HP:0000708): Atypical behavior is an abnormality in a person's actions that can be controlled or modulated by the will of the individual. While abnormal behaviors can be difficult to control, they are distinct from other abnormal actions that cannot be affected by the individual's will. Evidence: TAS. Frequency: Frequent (HP:0040282). (ORPHA:1398)
- Seizure (HP:0001250): A seizure is an intermittent abnormality of nervous system physiology characterized by a transient occurrence of signs and/or symptoms due to abnormal excessive or synchronous neuronal activity in the brain. Evidence: TAS. Frequency: Frequent (HP:0040282). (ORPHA:1398)
- Ataxia (HP:0001251): Ataxia refers to impaired coordination of voluntary muscle movement. Cerebellar ataxia refers to ataxia due to dysfunction of the cerebellum. This causes a variety of elementary neurological deficits including asynergy (lack of coordination between muscles, limbs and joints), dysmetria (lack of ability to judge distances that can lead to under- or overshoot in grasping movements), and dysdiadochokinesia (inability to perform rapid movements requiring antagonizing muscle groups to be switched on and off repeatedly). Evidence: TAS. Frequency: Very frequent (HP:0040281). (ORPHA:1398)
- Hypotonia (HP:0001252): Hypotonia is an abnormally low muscle tone (the amount of tension or resistance to movement in a muscle). Even when relaxed, muscles have a continuous and passive partial contraction which provides some resistance to passive stretching. Hypotonia thus manifests as diminished resistance to passive stretching. Hypotonia is not the same as muscle weakness, although the two conditions can co-exist. Evidence: TAS. Frequency: Very frequent (HP:0040281). (ORPHA:1398)
- Hypertonia (HP:0001276): A condition in which there is increased muscle tone so that arms or legs, for example, are stiff and difficult to move. Evidence: TAS. Frequency: Frequent (HP:0040282). (ORPHA:1398)
- Abnormal speech pattern (HP:0002167): An abnormality in the sound (volume) or cadence (rate) of speech. Evidence: TAS. Frequency: Frequent (HP:0040282). (ORPHA:1398)
- Abnormality of movement (HP:0100022): An abnormality of movement with a neurological basis characterized by changes in coordination and speed of voluntary movements. Evidence: TAS. Frequency: Frequent (HP:0040282). (ORPHA:1398)